- Clubbing (HP:0001217, a Human Phenotype Ontology term): Broadening of the soft tissues (non-edematous swelling of soft tissues) of the digital tips in all dimensions associated with an increased longitudinal and lateral curvature of the nails. Evidence: TAS. (OMIM:136000)
- Adermatoglyphia (HP:0007455, a Human Phenotype Ontology term). Evidence: TAS. (OMIM:136000)
- Autosomal dominant inheritance (HP:0000006, a Human Phenotype Ontology term): A mode of inheritance that is observed for traits related to a gene encoded on one of the autosomes (i.e., the human chromosomes 1-22) in which a trait manifests in heterozygotes. In the context of medical genetics, an autosomal dominant disorder is caused when a single copy of the mutant allele is present. Males and females are affected equally, and can both transmit the disorder with a risk of 50% for each child of inheriting the mutant allele. Evidence: TAS. (OMIM:136000)
- Palmar hyperkeratosis (HP:0010765, a Human Phenotype Ontology term): Abnormal thickening of the skin localized to the palm of the hand. Evidence: TAS. (OMIM:136000)
These phenotypes are associated with the disease isolated congenital adermatoglyphia (OMIM:136000, an entry in Online Mendelian Inheritance in Man).